Phenotypes associated with the disease Intrahepatic cholestasis of pregnancy (ORPHA:69665):
- Preeclampsia (HP:0100602): Pregnancy-induced hypertension in association with significant amounts of protein in the urine. Evidence: TAS. Frequency: Occasional (HP:0040283). (ORPHA:69665)
- Hypothyroidism (HP:0000821): Deficiency of thyroid hormone. Evidence: TAS. Frequency: Very rare (HP:0040284). (ORPHA:69665)
- Jaundice (HP:0000952): Yellow pigmentation of the skin due to bilirubin, which in turn is the result of increased bilirubin concentration in the bloodstream. Evidence: TAS. Frequency: Very rare (HP:0040284). (ORPHA:69665)
- Cholecystitis (HP:0001082): The presence of inflammatory changes in the gallbladder. Evidence: TAS. Frequency: Very rare (HP:0040284). (ORPHA:69665)
- Tremor (HP:0001337): An unintentional, oscillating to-and-fro muscle movement about a joint axis. Evidence: TAS. Frequency: Very rare (HP:0040284). (ORPHA:69665)
- Small for gestational age (HP:0001518): Smaller than normal size according to sex and gestational age related norms, defined as a weight below the 10th percentile for the gestational age. Evidence: TAS. Frequency: Very rare (HP:0040284). (ORPHA:69665)
- Ascites (HP:0001541): Accumulation of fluid in the peritoneal cavity (between the layers of the peritoneum that lines the abdomen). Evidence: TAS. Frequency: Very rare (HP:0040284). (ORPHA:69665)
- Premature birth (HP:0001622): The birth of a baby of less than 37 weeks of gestational age. Evidence: TAS. Frequency: Very rare (HP:0040284). (ORPHA:69665)
- Abnormality of the pancreas (HP:0001732): An abnormality of the pancreas. Evidence: TAS. Frequency: Very rare (HP:0040284). (ORPHA:69665)
- Abdominal pain (HP:0002027): An unpleasant sensation characterized by physical discomfort (such as pricking, throbbing, or aching) and perceived to originate in the abdomen. Evidence: TAS. Frequency: Very rare (HP:0040284). (ORPHA:69665)
- Asterixis (HP:0012164): A clinical sign indicating a lapse of posture and is usually manifest by a bilateral flapping tremor at the wrist, metacarpophalangeal, and hip joints. Evidence: TAS. Frequency: Very rare (HP:0040284). (ORPHA:69665)
- Pruritus (HP:0000989): Pruritus is an itch or a sensation that makes a person want to scratch. This term refers to an abnormally increased disposition to experience pruritus. Evidence: TAS. Frequency: Very frequent (HP:0040281). (ORPHA:69665)
- Increased serum bile acid concentration (HP:0012202): An increase in the concentration of bile acid in the blood. Evidence: TAS. Frequency: Very frequent (HP:0040281). (ORPHA:69665)
- Elevated circulating hepatic transaminase concentration (HP:0002910): Elevations of the levels of SGOT and SGPT in the serum. SGOT (serum glutamic oxaloacetic transaminase) and SGPT (serum glutamic pyruvic transaminase) are transaminases primarily found in the liver and heart and are released into the bloodstream as the result of liver or heart damage. SGOT and SGPT are used clinically mainly as markers of liver damage. Evidence: TAS. Frequency: Frequent (HP:0040282). (ORPHA:69665)
- Abnormality of the digestive system (HP:0025031). Evidence: TAS. Frequency: Frequent (HP:0040282). (ORPHA:69665)
- Insomnia (HP:0100785): Persistent difficulty in starting or maintaining sleep, or waking up earlier than desired, despite having adequate opportunities and conditions for sleep. Evidence: TAS. Frequency: Frequent (HP:0040282). (ORPHA:69665)
- Depression (HP:0000716): Frequently experiencing feelings of being down, miserable, and/or hopeless; struggling to recover from these moods; having a pessimistic outlook on the future; feeling a pervasive sense of shame; having a low self-worth; experiencing thoughts of suicide and engaging in suicidal behavior. Evidence: TAS. Frequency: Occasional (HP:0040283). (ORPHA:69665)
- Neonatal respiratory distress (HP:0002643): Respiratory difficulty as newborn. Evidence: TAS. Frequency: Occasional (HP:0040283). (ORPHA:69665)
- Hyperbilirubinemia (HP:0002904): An increased amount of bilirubin in the blood. Evidence: TAS. Frequency: Occasional (HP:0040283). (ORPHA:69665)
- Elevated circulating alkaline phosphatase concentration (HP:0003155): Abnormally increased serum levels of alkaline phosphatase activity. Evidence: TAS. Frequency: Occasional (HP:0040283). (ORPHA:69665)
- Abnormal circulating interleukin concentration (HP:0011117): The concentration of an interleukin (a class of cytokines) is outside the limits of normal. Evidence: TAS. Frequency: Occasional (HP:0040283). (ORPHA:69665)
- Meconium stained amniotic fluid (HP:0012420): Amniotic fluid containing the earliest stools of a mammalian infant. Evidence: TAS. Frequency: Occasional (HP:0040283). (ORPHA:69665)
- Abnormal pineal melatonin secretion (HP:0012689): An anomaly in the amount or timing of melatonin secretion by the pineal gland. Note that melatonin is also synthesized by multiple tissues outside of the pineal gland. Evidence: TAS. Frequency: Occasional (HP:0040283). (ORPHA:69665)
- Pruritus on foot (HP:0030900): Pruritus is an itch or a sensation that makes a person want to scratch. This term refers to an abnormally increased sensation of itching over the skin of the foot. Evidence: TAS. Frequency: Occasional (HP:0040283). (ORPHA:69665)
- Palmar pruritus (HP:0031248): Pruritus is an itch or a sensation that makes a person want to scratch. This term refers to an abnormally increased sensation of itching over the palm(s) of the hand. Evidence: TAS. Frequency: Occasional (HP:0040283). (ORPHA:69665)
Not associated with this disease:
- Skin rash (HP:0000988): A red eruption of the skin. Evidence: TAS. (ORPHA:69665)
- Autoimmunity (HP:0002960): The occurrence of an immune reaction against the organism's own cells or tissues. Evidence: TAS. (ORPHA:69665)